- Acanthosis nigricans (HP:0000956): A dermatosis characterized by thickened, hyperpigmented plaques, typically on the intertriginous surfaces and neck. Evidence: IEA. (OMIM:100600)
- Autosomal dominant inheritance (HP:0000006): A mode of inheritance that is observed for traits related to a gene encoded on one of the autosomes (i.e., the human chromosomes 1-22) in which a trait manifests in heterozygotes. In the context of medical genetics, an autosomal dominant disorder is caused when a single copy of the mutant allele is present. Males and females are affected equally, and can both transmit the disorder with a risk of 50% for each child of inheriting the mutant allele. Evidence: IEA. (OMIM:100600)
These phenotypes are associated with the disease familial acanthosis nigricans (OMIM:100600).